Phenotypes associated with the disease premature ovarian failure 20 (OMIM:619938):
- Secondary amenorrhea (HP:0000869). Evidence: PCS. Frequency: 2/2. (PMID:28541421)
- Elevated circulating luteinizing hormone level (HP:0011969): An elevated concentration of luteinizing hormone in the blood. Evidence: PCS. Frequency: 2/2. (PMID:28541421)
- Female infertility (HP:0008222). Evidence: PCS. Frequency: 2/2. (PMID:28541421)
- Young adult onset (HP:0011462): Onset of disease at the age of between 16 and 40 years. Evidence: PCS. Frequency: 2/2. (PMID:28541421)
- Elevated circulating follicle stimulating hormone level (HP:0008232): An elevated concentration of follicle-stimulating hormone in the blood. Evidence: PCS. Frequency: 2/2. (PMID:28541421)
- Autosomal recessive inheritance (HP:0000007): A mode of inheritance that is observed for traits related to a gene encoded on one of the autosomes (i.e., the human chromosomes 1-22) in which a trait manifests in individuals with two pathogenic alleles, either homozygotes (two copies of the same mutant allele) or compound heterozygotes (whereby each copy of a gene has a distinct mutant allele). Evidence: PCS. (PMID:28541421)